Phenotypes associated with the disease Sternal cleft (ORPHA:2017):
- Abnormal thorax morphology (HP:0000765): Any abnormality of the thorax (the region of the body formed by the sternum, the thoracic vertebrae and the ribs). Evidence: TAS. Frequency: Very frequent (HP:0040281). (ORPHA:2017)
- Abnormal sternum morphology (HP:0000766): An anomaly of the sternum, also known as the breastbone. Evidence: TAS. Frequency: Very frequent (HP:0040281). (ORPHA:2017)
- Bifid sternum (HP:0010309): The sternal cleft is a rare congenital anomaly resulting from a fusion failure of the sternum. Evidence: TAS. Frequency: Very frequent (HP:0040281). (ORPHA:2017)
- Dyspnea (HP:0002094): Difficult or labored breathing. Dyspnea is a subjective feeling only the patient can rate, e.g., on a Borg scale. Evidence: TAS. Frequency: Frequent (HP:0040282). (ORPHA:2017)
- Recurrent respiratory infections (HP:0002205): An increased susceptibility to respiratory infections as manifested by a history of recurrent respiratory infections. Evidence: TAS. Frequency: Frequent (HP:0040282). (ORPHA:2017)
- Cough (HP:0012735): A sudden, audible expulsion of air from the lungs through a partially closed glottis, preceded by inhalation. Evidence: TAS. Frequency: Frequent (HP:0040282). (ORPHA:2017)